Phenotypes associated with the disease Oral submucous fibrosis (ORPHA:357154):
- Narrow mouth (HP:0000160): Distance between the commissures of the mouth more than 2 SD below the mean. Alternatively, an apparently decreased width of the oral aperture (subjective). Evidence: TAS. Frequency: Very frequent (HP:0040281). (ORPHA:357154)
- Abnormal oral cavity morphology (HP:0000163): Abnormality of the oral cavity, i.e., the opening or hollow part of the mouth. Evidence: TAS. Frequency: Very frequent (HP:0040281). (ORPHA:357154)
- Trismus (HP:0000211): Limitation in the ability to open the mouth. Evidence: TAS. Frequency: Frequent (HP:0040282). (ORPHA:357154)
- Abnormality of the pharynx (HP:0000600): An anomaly of the pharynx, i.e., of the tubular structure extending from the base of the skull superiorly to the esophageal inlet inferiorly. Evidence: TAS. Frequency: Very frequent (HP:0040281). (ORPHA:357154)
- Flexion contracture (HP:0001371): A flexion contracture is a bent (flexed) joint that cannot be straightened actively or passively. It is thus a chronic loss of joint motion due to structural changes in muscle, tendons, ligaments, or skin that prevents normal movement of joints. Evidence: TAS. Frequency: Frequent (HP:0040282). (ORPHA:357154)
- Oropharyngeal squamous cell carcinoma (HP:0012182): A squamous cell carcinoma that originates in the oropharnyx. Evidence: TAS. Frequency: Occasional (HP:0040283). (ORPHA:357154)
- Cheilitis (HP:0100825): Inflammation of the lip. Evidence: TAS. Frequency: Very frequent (HP:0040281). (ORPHA:357154)